Phenotypes associated with the disease global developmental delay with or without impaired intellectual development (OMIM:618330):
- Short stature (HP:0004322): A height below that which is expected according to age and gender norms. Although there is no universally accepted definition of short stature, many refer to "short stature" as height more than 2 standard deviations below the mean for age and gender (or below the 3rd percentile for age and gender dependent norms). Evidence: PCS. Frequency: 2/9. (PMID:30014507)
- Hypotonia (HP:0001252): Hypotonia is an abnormally low muscle tone (the amount of tension or resistance to movement in a muscle). Even when relaxed, muscles have a continuous and passive partial contraction which provides some resistance to passive stretching. Hypotonia thus manifests as diminished resistance to passive stretching. Hypotonia is not the same as muscle weakness, although the two conditions can co-exist. Evidence: PCS. Frequency: 3/9. (PMID:30014507)
- Infantile onset (HP:0003593): Onset of signs or symptoms of disease between 28 days to one year of life. Evidence: PCS. Frequency: 9/9. (PMID:30014507)
- Motor delay (HP:0001270): A type of Developmental delay characterized by a delay in acquiring motor skills. Evidence: PCS. Frequency: 7/9. (PMID:30014507)
- Widened subarachnoid space (HP:0012704): An increase in size of the anatomic space between the arachnoid membrane and pia mater. Evidence: PCS. Frequency: 1/9. (PMID:30014507)
- Ventricular septal defect (HP:0001629): A hole between the two bottom chambers (ventricles) of the heart. The defect is centered around the most superior aspect of the ventricular septum. Evidence: PCS. Frequency: 1/9. (PMID:30014507)
- Broad forehead (HP:0000337): Width of the forehead or distance between the frontotemporales is more than two standard deviations above the mean (objective); or apparently increased distance between the two sides of the forehead. Evidence: PCS. Frequency: 1/9. (PMID:30014507)
- Bulbous nose (HP:0000414): Increased volume and globular shape of the anteroinferior aspect of the nose. Evidence: PCS. Frequency: 2/9. (PMID:30014507)
- Long palpebral fissure (HP:0000637): Distance between medial and lateral canthi is more than two standard deviations above the mean for age (objective); or, apparently increased length of the palpebral fissures. Evidence: PCS. Frequency: 1/9. (PMID:30014507)
- Thin upper lip vermilion (HP:0000219): Height of the vermilion of the upper lip in the midline more than 2 SD below the mean. Alternatively, an apparently reduced height of the vermilion of the upper lip in the frontal view (subjective). Evidence: PCS. Frequency: 1/9. (PMID:30014507)
- Patent ductus arteriosus (HP:0001643): In utero, the ductus arteriosus (DA) serves to divert ventricular output away from the lungs and toward the placenta by connecting the main pulmonary artery to the descending aorta. A patent ductus arteriosus (PDA) in the first 3 days of life is a physiologic shunt in healthy term and preterm newborn infants, and normally is substantially closed within about 24 hours after bith and completely closed after about three weeks. Failure of physiologcal closure is referred to a persistent or patent ductus arteriosus (PDA). Depending on the degree of left-to-right shunting, PDA can have clinical consequences. Evidence: PCS. Frequency: 2/9. (PMID:30014507)
- Intellectual disability (HP:0001249): The term intellectual disability or intellectual developmental disorder is used to describe significantly sub-average intellectual and adaptive functioning based on clinical assessment and as measured by individually administered, appropriately normed, standardized and validated tests of intellectual functioning and adaptive behavior, with onset during the developmental period from infancy through adolescence. Evidence: PCS. Frequency: 6/9. (PMID:30014507)
- Oligodontia (HP:0000677): The absence of six or more teeth from the normal series by a failure to develop. Evidence: PCS. Frequency: 1/9. (PMID:30014507)
- Lateral ventricle dilatation (HP:0006956). Evidence: PCS. Frequency: 1/9. (PMID:30014507)
- Delayed speech and language development (HP:0000750): A degree of language development that is significantly below the norm for a child of a specified age. Evidence: PCS. Frequency: 9/9. (PMID:30014507)
- Long face (HP:0000276): Facial height (length) is more than 2 standard deviations above the mean (objective); or, an apparent increase in the height (length) of the face (subjective). Evidence: PCS. Frequency: 1/9. (PMID:30014507)
- Global developmental delay (HP:0001263): A delay in the achievement of motor or mental milestones in the domains of development of a child, including motor skills, speech and language, cognitive skills, and social and emotional skills. This term should only be used to describe children younger than five years of age. Evidence: PCS. Frequency: 9/9. (PMID:30014507)
- Pulmonary sequestration (HP:0100632): The presence of a piece lung tissue which is not attached to the pulmonary blood supply and does not communicate with the other lung tissue (not connected to the standard bronchial airways and not performing a function in respiration). Evidence: PCS. Frequency: 1/9. (PMID:30014507)
- Poor fine motor coordination (HP:0007010): An abnormality of the ability (skills) to perform a precise movement of small muscles with the intent to perform a specific act. Fine motor skills are required to mediate movements of the wrists, hands, fingers, feet, and toes. Evidence: PCS. Frequency: 2/9. (PMID:30014507)
- Pectus excavatum (HP:0000767): A defect of the chest wall characterized by a depression of the sternum, giving the chest ("pectus") a caved-in ("excavatum") appearance. Evidence: PCS. Frequency: 1/9. (PMID:30014507)
- Hypotelorism (HP:0000601): Interpupillary distance less than 2 SD below the mean (alternatively, the appearance of an decreased interpupillary distance or closely spaced eyes). Evidence: PCS. Frequency: 1/9. (PMID:30014507)
- Plagiocephaly (HP:0001357): Asymmetric head shape, which is usually a combination of unilateral occipital flattening with ipsilateral frontal prominence, leading to rhomboid cranial shape. Evidence: PCS. Frequency: 1/9. (PMID:30014507)
- Frontal bossing (HP:0002007): Bilateral bulging of the lateral frontal bone prominences with relative sparing of the midline. Evidence: PCS. Frequency: 2/9. (PMID:30014507)
- Hypospadias (HP:0000047): Abnormal position of urethral meatus on the ventral penile shaft (underside) characterized by displacement of the urethral meatus from the tip of the glans penis to the ventral surface of the penis, scrotum, or perineum. Evidence: PCS. Frequency: 2/9. (PMID:30014507)
- Atrial septal defect (HP:0001631): Atrial septal defect (ASD) is a congenital abnormality of the interatrial septum that enables blood flow between the left and right atria via the interatrial septum. Evidence: PCS. Frequency: 1/9. (PMID:30014507)
- Autosomal dominant inheritance (HP:0000006): A mode of inheritance that is observed for traits related to a gene encoded on one of the autosomes (i.e., the human chromosomes 1-22) in which a trait manifests in heterozygotes. In the context of medical genetics, an autosomal dominant disorder is caused when a single copy of the mutant allele is present. Males and females are affected equally, and can both transmit the disorder with a risk of 50% for each child of inheriting the mutant allele. Evidence: PCS. (PMID:30014507)
- Low-set ears (HP:0000369): Upper insertion of the ear to the scalp below an imaginary horizontal line drawn between the inner canthi of the eye and extending posteriorly to the ear. Evidence: PCS. Frequency: 1/9. (PMID:30014507)